- Thin skin (HP:0000963): Reduction in thickness of the skin, generally associated with a loss of suppleness and elasticity of the skin. Evidence: TAS. Frequency: Frequent (HP:0040282). (ORPHA:745)
- Purpura (HP:0000979): Purpura (from Latin: purpura, meaning purple) is the appearance of red or purple discolorations on the skin that do not blanch on applying pressure. They are caused by bleeding underneath the skin. This term refers to an abnormally increased susceptibility to developing purpura. Purpura are larger than petechiae. Evidence: TAS. Frequency: Frequent (HP:0040282). (ORPHA:745)
- Abnormal skin pigmentation (HP:0001000): An abnormality of the pigmentation of the skin. Evidence: TAS. Frequency: Occasional (HP:0040283). (ORPHA:745)
- Warfarin-induced skin necrosis (HP:0001038). Evidence: TAS. Frequency: Occasional (HP:0040283). (ORPHA:745)
- Pulmonary embolism (HP:0002204): An embolus (that is, an abnormal particle circulating in the blood) located in the pulmonary artery and thereby blocking blood circulation to the lung. Usually the embolus is a blood clot that has developed in an extremity (for instance, a deep venous thrombosis), detached, and traveled through the circulation before becoming trapped in the pulmonary artery. Evidence: TAS. Frequency: Occasional (HP:0040283). (ORPHA:745)
- Venous thrombosis (HP:0004936): Formation of a blood clot (thrombus) inside a vein, causing the obstruction of blood flow. Evidence: TAS. Frequency: Frequent (HP:0040282). (ORPHA:745)
- Venous insufficiency (HP:0005293). Evidence: TAS. Frequency: Occasional (HP:0040283). (ORPHA:745)
- Aplasia/Hypoplasia of the skin (HP:0008065). Evidence: TAS. Frequency: Frequent (HP:0040282). (ORPHA:745)
- Abnormal cerebral vascular morphology (HP:0100659): An anomaly of the cerebral blood vessels. Evidence: TAS. Frequency: Occasional (HP:0040283). (ORPHA:745)
- Gangrene (HP:0100758): A serious and potentially life-threatening condition that arises when a considerable mass of body tissue dies (necrosis). Evidence: TAS. Frequency: Occasional (HP:0040283). (ORPHA:745)
These phenotypes are associated with the disease Severe hereditary thrombophilia due to congenital protein C deficiency (ORPHA:745).